- Ciliary dyskinesia (HP:0012265): A deviation from the normally well coordinated pattern of intracellular and intercellular synchrony of motile cilia. Dyskinetic cilia usually beat out of synchrony relative to neighboring cilia. Evidence: PCS. (PMID:23261302)
- Situs inversus totalis (HP:0001696): A left-right reversal (or mirror reflection) of the anatomical location of the major thoracic and abdominal organs. Evidence: PCS. Frequency: 3/6. (PMID:23261302)
- Bronchiectasis (HP:0002110): Persistent abnormal dilatation of the bronchi owing to localized and irreversible destruction and widening of the large airways. Evidence: PCS. Frequency: 5/6. (PMID:23261302)
- Infantile onset (HP:0003593): Onset of signs or symptoms of disease between 28 days to one year of life. Evidence: PCS. Frequency: 3/6. (PMID:23261302)
- Decreased nasal nitric oxide (HP:0033036): Reduced level of nasal nitric oxide (nNO). Current American Thoracic Society/European Respiratory Society (ATS/ERS) guidelines for nNO measurements recommend air aspiration via a nasal probe while the subject exhales through the mouth against resistance in order to maintain velum closure. Evidence: PCS. Frequency: 6/6. (PMID:23261302)
- Autosomal recessive inheritance (HP:0000007): A mode of inheritance that is observed for traits related to a gene encoded on one of the autosomes (i.e., the human chromosomes 1-22) in which a trait manifests in individuals with two pathogenic alleles, either homozygotes (two copies of the same mutant allele) or compound heterozygotes (whereby each copy of a gene has a distinct mutant allele). Evidence: PCS. (PMID:23261302)
- Recurrent otitis media (HP:0000403): Increased susceptibility to otitis media, as manifested by recurrent episodes of otitis media. Evidence: PCS. Frequency: 6/6. (PMID:23261302)
- Recurrent respiratory infections (HP:0002205): An increased susceptibility to respiratory infections as manifested by a history of recurrent respiratory infections. Evidence: PCS. (PMID:23261302)
- Recurrent sinusitis (HP:0011108): A recurrent form of sinusitis. Evidence: PCS. Frequency: 6/6. (PMID:23261302)
- Neonatal respiratory distress (HP:0002643): Respiratory difficulty as newborn. Evidence: PCS. Frequency: 3/5. Onset: Neonatal onset (HP:0003623). (PMID:23261302)
- Neonatal onset (HP:0003623): Onset of signs or symptoms of disease within the first 28 days of life. Evidence: PCS. Frequency: 3/6. (PMID:23261302)
These phenotypes are associated with the disease primary ciliary dyskinesia 3 (OMIM:608644).